- Abnormality of the coagulation cascade (HP:0003256): An abnormality of the coagulation cascade, which is comprised of the contact activation pathway (also known as the intrinsic pathway) and the tissue factor pathway (also known as the extrinsic pathway) as well as cofactors and regulators. Evidence: TAS. (OMIM:612015)
- Short stature (HP:0004322): A height below that which is expected according to age and gender norms. Although there is no universally accepted definition of short stature, many refer to "short stature" as height more than 2 standard deviations below the mean for age and gender (or below the 3rd percentile for age and gender dependent norms). Evidence: TAS. (OMIM:612015)
- Recurrent lower respiratory tract infections (HP:0002783): An increased susceptibility to lower respiratory tract infections as manifested by a history of recurrent lower respiratory tract infections. Evidence: PCS. Frequency: 2/3. (PMID:19701946)
- Seizure (HP:0001250): A seizure is an intermittent abnormality of nervous system physiology characterized by a transient occurrence of signs and/or symptoms due to abnormal excessive or synchronous neuronal activity in the brain. Evidence: PCS. Frequency: 4/4. (PMID:19701946;PMID:18313027)
- Hypotonia (HP:0001252): Hypotonia is an abnormally low muscle tone (the amount of tension or resistance to movement in a muscle). Even when relaxed, muscles have a continuous and passive partial contraction which provides some resistance to passive stretching. Hypotonia thus manifests as diminished resistance to passive stretching. Hypotonia is not the same as muscle weakness, although the two conditions can co-exist. Evidence: PCS. Frequency: 4/4. (PMID:19701946;PMID:18313027)
- Ataxia (HP:0001251): Ataxia refers to impaired coordination of voluntary muscle movement. Cerebellar ataxia refers to ataxia due to dysfunction of the cerebellum. This causes a variety of elementary neurological deficits including asynergy (lack of coordination between muscles, limbs and joints), dysmetria (lack of ability to judge distances that can lead to under- or overshoot in grasping movements), and dysdiadochokinesia (inability to perform rapid movements requiring antagonizing muscle groups to be switched on and off repeatedly). Evidence: TAS. (OMIM:612015)
- Hepatomegaly (HP:0002240): Abnormally increased size of the liver. Evidence: PCS. Frequency: 1/1. (PMID:18313027)
- Infantile onset (HP:0003593): Onset of signs or symptoms of disease between 28 days to one year of life. Evidence: PCS. Frequency: 3/3. (PMID:19701946)
- Severe intellectual disability (HP:0010864): Severe intellectual disability (ID) is defined as a type of ID characterized by severely sub-average adaptive functioning and intellectual functioning, with an intelligence quotient (IQ) the range of 20-34. Evidence: PCS. Frequency: 3/3. (PMID:19701946)
- Failure to thrive (HP:0001508): Failure to thrive (FTT) refers to a child whose physical growth is substantially below the norm. Evidence: PCS. Frequency: 3/3. (PMID:19701946)
- Reduced visual acuity (HP:0007663). Evidence: PCS. Frequency: 3/3. (PMID:19701946)
- Hyperreflexia (HP:0001347): Hyperreflexia is the presence of hyperactive stretch reflexes of the muscles. Evidence: TAS. (OMIM:612015)
- Type I transferrin isoform profile (HP:0003642): Abnormal transferrin isoform profile consistent with a type I congenital disorder of glycosylation. In the traditional nomenclature for congenital disorders of glycosylation, absence of entire glycans was designated type I, and loss of one or more monosaccharides as type II. Evidence: PCS. Frequency: 3/3. (PMID:19701946)
- Microcephaly (HP:0000252): Head circumference below 2 standard deviations below the mean for age and gender. Evidence: PCS. Frequency: 2/3. (PMID:19701946)
- Cerebral atrophy (HP:0002059): Atrophy (wasting, decrease in size of cells or tissue) affecting the cerebrum. Evidence: PCS. Frequency: 1/3. (PMID:19701946)
- Feeding difficulties (HP:0011968): Impaired ability to eat related to problems gathering food and getting ready to suck, chew, or swallow it. Evidence: PCS. Frequency: 3/3. (PMID:19701946)
- Global developmental delay (HP:0001263): A delay in the achievement of motor or mental milestones in the domains of development of a child, including motor skills, speech and language, cognitive skills, and social and emotional skills. This term should only be used to describe children younger than five years of age. Evidence: PCS. Frequency: 1/1. (PMID:18313027)
- Inverted nipples (HP:0003186): The presence of nipples that instead of pointing outward are retracted inwards. Evidence: PCS. Frequency: 2/3. (PMID:19701946)
- Short neck (HP:0000470): Diminished length of the neck. Evidence: PCS. Frequency: 2/3. (PMID:19701946)
- Adducted thumb (HP:0001181): In the resting position, the tip of the thumb is on, or near, the palm, close to the base of the fourth or fifth finger. Evidence: PCS. Frequency: 2/2. (PMID:19701946)
- Respiratory insufficiency (HP:0002093). Evidence: PCS. Frequency: 2/3. (PMID:19701946)
- Pes valgus (HP:0008081): An outward (valgus) deviation of the calcaneus relative to the longitudinal axis of the lower leg at the talocalcaneal (subtalar) joint, such that the heel is everted. Evidence: PCS. Frequency: 3/3. (PMID:19701946)
- Sensorineural hearing impairment (HP:0000407): A type of hearing impairment in one or both ears related to an abnormal functionality of the cochlear nerve. Evidence: PCS. Frequency: 3/3. (PMID:19701946)
- Autosomal recessive inheritance (HP:0000007): A mode of inheritance that is observed for traits related to a gene encoded on one of the autosomes (i.e., the human chromosomes 1-22) in which a trait manifests in individuals with two pathogenic alleles, either homozygotes (two copies of the same mutant allele) or compound heterozygotes (whereby each copy of a gene has a distinct mutant allele). Evidence: PCS. (PMID:18313027)
- Spasticity (HP:0001257): A motor disorder characterized by a velocity-dependent increase in tonic stretch reflexes with increased muscle tone, exaggerated (hyperexcitable) tendon reflexes. Evidence: TAS. (OMIM:612015)
- Micrognathia (HP:0000347): Developmental hypoplasia of the mandible. Evidence: PCS. Frequency: 2/3. (PMID:19701946)
- Myoclonus (HP:0001336): Very brief, involuntary random muscular contractions occurring at rest, in response to sensory stimuli, or accompanying voluntary movements. Evidence: PCS. Frequency: 3/3. (PMID:19701946)
These phenotypes are associated with the disease RFT1-congenital disorder of glycosylation (OMIM:612015).